Phenotypes associated with the disease hepatic adenomas, familial (OMIM:142330):
- Maturity-onset diabetes of the young (HP:0004904): The term Maturity-onset diabetes of the young (MODY) was initially used for patients diagnosed with fasting hyperglycemia that could be treated without insulin for more than two years, where the initial diagnosis was made at a young age (under 25 years). Thus, MODY combines characteristics of type 1 diabetes (young age at diagnosis) and type 2 diabetes (less insulin dependence than type 1 diabetes). The term MODY is now most often used to refer to a group of monogenic diseases with these characteristics. Here, the term is used to describe hyperglycemia diagnosed at a young age with no or minor insulin dependency, no evidence of insulin resistance, and lack of evidence of autoimmune destruction of the beta cells. Evidence: IEA. (OMIM:142330)
- Polycystic ovaries (HP:0000147). Evidence: IEA. (OMIM:142330)
- Autosomal dominant inheritance (HP:0000006): A mode of inheritance that is observed for traits related to a gene encoded on one of the autosomes (i.e., the human chromosomes 1-22) in which a trait manifests in heterozygotes. In the context of medical genetics, an autosomal dominant disorder is caused when a single copy of the mutant allele is present. Males and females are affected equally, and can both transmit the disorder with a risk of 50% for each child of inheriting the mutant allele. Evidence: IEA. (OMIM:142330)
- Hepatocellular adenoma (HP:0012028): A benign tumor of the liver of presumably epithelial origin. Evidence: TAS. (OMIM:142330)